Phenotypes associated with the disease dermatopathia pigmentosa reticularis (OMIM:125595):
- Alopecia of scalp (HP:0002293). Evidence: TAS. (OMIM:125595)
- Abnormal conjunctiva morphology (HP:0000502): An abnormality of the conjunctiva. Evidence: IEA. (OMIM:125595)
- Adermatoglyphia (HP:0007455). Evidence: PCS. (PMID:16960809)
- Reticular hyperpigmentation (HP:0007588): Increased pigmentation of the skin with a netlike (reticular) pattern. Evidence: PCS. (PMID:16960809)
- Hypohidrosis (HP:0000966): Abnormally diminished capacity to sweat. Evidence: PCS. (PMID:16960809)
- Palmoplantar hyperkeratosis (HP:0000972): Abnormal thickening of the skin localized to the palm of the hand and the sole of the foot. Evidence: PCS. (PMID:16960809)
- Nail dystrophy (HP:0008404): Onychodystrophy (nail dystrophy) refers to nail changes apart from changes of the color (nail dyschromia) and involves partial or complete disruption of the various keratinous layers of the nail plate. Evidence: TAS. (OMIM:125595)
- Autosomal dominant inheritance (HP:0000006): A mode of inheritance that is observed for traits related to a gene encoded on one of the autosomes (i.e., the human chromosomes 1-22) in which a trait manifests in heterozygotes. In the context of medical genetics, an autosomal dominant disorder is caused when a single copy of the mutant allele is present. Males and females are affected equally, and can both transmit the disorder with a risk of 50% for each child of inheriting the mutant allele. Evidence: PCS. (PMID:16960809)
- Reticulate pigmentation of oral mucosa (HP:0012788): A net-like pattern of increased pigmentation of the oral cavity. Evidence: TAS. (OMIM:125595)